- Delayed speech and language development (HP:0000750): A degree of language development that is significantly below the norm for a child of a specified age. Evidence: PCS. Frequency: 3/3. (PMID:30970188)
- Febrile seizure (within the age range of 3 months to 6 years) (HP:0002373): A febrile seizure is any type of seizure (most often a generalized tonic-clonic seizure) occurring with fever (at least 38 degrees Celsius) but in the absence of central nervous system infection, severe metabolic disturbance or other alternative precipitant in children between the ages of 3 months and 6 years. Evidence: PCS. Frequency: 1/3. (PMID:30970188)
- Cerebellar atrophy (HP:0001272): Cerebellar atrophy is defined as a cerebellum with initially normal structures, in a posterior fossa with normal size, which displays enlarged fissures (interfolial spaces) in comparison to the foliae secondary to loss of tissue. Cerebellar atrophy implies irreversible loss of tissue and result from an ongoing progressive disease until a final stage is reached or a single injury, e.g. an intoxication or infectious event. Evidence: PCS. Frequency: 1/3. Onset: Juvenile onset (HP:0003621). (PMID:30970188)
- Childhood onset (HP:0011463): Onset of disease at the age of between 1 and 5 years. Evidence: PCS. Frequency: 3/3. (PMID:30970188)
- Global developmental delay (HP:0001263): A delay in the achievement of motor or mental milestones in the domains of development of a child, including motor skills, speech and language, cognitive skills, and social and emotional skills. This term should only be used to describe children younger than five years of age. Evidence: PCS. Frequency: 3/3. (PMID:30970188)
- Autosomal recessive inheritance (HP:0000007): A mode of inheritance that is observed for traits related to a gene encoded on one of the autosomes (i.e., the human chromosomes 1-22) in which a trait manifests in individuals with two pathogenic alleles, either homozygotes (two copies of the same mutant allele) or compound heterozygotes (whereby each copy of a gene has a distinct mutant allele). Evidence: PCS. (PMID:30970188)
- Delayed gross motor development (HP:0002194): A type of motor delay characterized by a delay in acquiring the ability to control the large muscles of the body for walking, running, sitting, and crawling. Evidence: PCS. Frequency: 3/3. (PMID:30970188)
- Progressive cerebellar ataxia (HP:0002073). Evidence: PCS. Frequency: 3/3. (PMID:30970188)
- Hyperglutaminemia (HP:0003217): The concentration of glutamine in the blood circulation is above the upper limit of normal. Evidence: PCS. Frequency: 3/3. (PMID:30970188)
These phenotypes are associated with the disease global developmental delay, progressive ataxia, and elevated glutamine (OMIM:618412).